- Uterus didelphys (HP:0003762): A malformation of the uterus in which the uterus is present as a paired organ as a result of the failure of fusion of the mullerian ducts during embryogenesis. Evidence: IEA. (OMIM:146160)
- Postaxial hand polydactyly (HP:0001162): Supernumerary digits located at the ulnar side of the hand (that is, on the side with the fifth finger). Evidence: IEA. (OMIM:146160)
- Longitudinal vaginal septum (HP:0008740): The presence of a longitudinal vaginal septum, thereby creating a vaginal duplication. Evidence: IEA. (OMIM:146160)
- Split hand (HP:0001171): A condition in which middle parts of the hand (fingers and metacarpals) are missing giving a cleft appearance. The severity is very variable ranging from slightly hypoplastic middle fingers over absent middle fingers as far as oligo- or monodactyl hands. Evidence: IEA. (OMIM:146160)
- Autosomal dominant inheritance (HP:0000006): A mode of inheritance that is observed for traits related to a gene encoded on one of the autosomes (i.e., the human chromosomes 1-22) in which a trait manifests in heterozygotes. In the context of medical genetics, an autosomal dominant disorder is caused when a single copy of the mutant allele is present. Males and females are affected equally, and can both transmit the disorder with a risk of 50% for each child of inheriting the mutant allele. Evidence: IEA. (OMIM:146160)
These phenotypes are associated with the disease mullerian duct anomalies-limb anomalies syndrome (OMIM:146160).